Phenotypes associated with the disease mitochondrial hypertrophic cardiomyopathy with lactic acidosis due to MTO1 deficiency (OMIM:614702):
- Poor speech (HP:0002465). Evidence: TAS. (OMIM:614702)
- Congenital onset (HP:0003577): A phenotypic abnormality that is present at birth. Evidence: PCS. Frequency: 2/3. (PMID:22608499)
- Pleural effusion (HP:0002202): The presence of an excessive amount of fluid in the pleural cavity. Evidence: PCS. Frequency: 1/3. (PMID:22608499)
- Dystonia (HP:0001332): An abnormally increased muscular tone that causes fixed abnormal postures. There is a slow, intermittent twisting motion that leads to exaggerated turning and posture of the extremities and trunk. Evidence: TAS. Frequency: Occasional (HP:0040283). (OMIM:614702)
- Seizure (HP:0001250): A seizure is an intermittent abnormality of nervous system physiology characterized by a transient occurrence of signs and/or symptoms due to abnormal excessive or synchronous neuronal activity in the brain. Evidence: TAS. Frequency: Occasional (HP:0040283). (OMIM:614702)
- Hypotonia (HP:0001252): Hypotonia is an abnormally low muscle tone (the amount of tension or resistance to movement in a muscle). Even when relaxed, muscles have a continuous and passive partial contraction which provides some resistance to passive stretching. Hypotonia thus manifests as diminished resistance to passive stretching. Hypotonia is not the same as muscle weakness, although the two conditions can co-exist. Evidence: PCS. Frequency: 1/3. (PMID:22608499)
- Infantile onset (HP:0003593): Onset of signs or symptoms of disease between 28 days to one year of life. Evidence: PCS. Frequency: 1/3. (PMID:22608499)
- Failure to thrive (HP:0001508): Failure to thrive (FTT) refers to a child whose physical growth is substantially below the norm. Evidence: TAS. (OMIM:614702)
- Hyperammonemia (HP:0001987): An increased concentration of ammonia in the blood. Evidence: PCS. Frequency: 1/3. (PMID:22608499)
- Hypoglycemia (HP:0001943): A decreased concentration of glucose in the blood. Evidence: PCS. Frequency: 1/3. (PMID:22608499)
- Metabolic acidosis (HP:0001942): Metabolic acidosis (MA) is characterized by a fall in blood pH due to a reduction of serum bicarbonate concentration. This can occur as a result of either the accumulation of acids (high anion gap MA) or the loss of bicarbonate from the gastrointestinal tract or the kidney (hyperchloremic MA). By definition, MA is not due to a respirary cause. Evidence: PCS. Frequency: 3/3. (PMID:22608499)
- Hyperalaninemia (HP:0003348): An increased concentration of alanine in the blood. Evidence: TAS. Frequency: Occasional (HP:0040283). (OMIM:614702)
- Lactic acidosis (HP:0003128): An abnormal buildup of lactic acid in the body, leading to acidification of the blood and other bodily fluids. Evidence: PCS. Frequency: 3/3. (PMID:22608499)
- Oligohydramnios (HP:0001562): Diminished amniotic fluid volume in pregnancy. Evidence: PCS. Frequency: 2/3. (PMID:22608499)
- Ascites (HP:0001541): Accumulation of fluid in the peritoneal cavity (between the layers of the peritoneum that lines the abdomen). Evidence: PCS. Frequency: 1/3. (PMID:22608499)
- Bradycardia (HP:0001662): A slower than normal heart rate (in adults, slower than 60 beats per minute). Evidence: PCS. Frequency: 3/3. (PMID:22608499)
- Cardiomegaly (HP:0001640): Increased size of the heart, clinically defined as an increased transverse diameter of the cardiac silhouette that is greater than or equal to 50% of the transverse diameter of the chest (increased cardiothoracic ratio) on a posterior-anterior projection of a chest radiograph or a computed tomography. Evidence: PCS. Frequency: 1/3. (PMID:22608499)
- Decreased activity of mitochondrial complex III (HP:0011924): A reduction in the activity of the mitochondrial respiratory chain complex III, which is part of the electron transport chain in mitochondria. Evidence: PCS. Frequency: 1/3. (PMID:22608499)
- Feeding difficulties (HP:0011968): Impaired ability to eat related to problems gathering food and getting ready to suck, chew, or swallow it. Evidence: PCS. Frequency: 1/3. (PMID:22608499)
- Global developmental delay (HP:0001263): A delay in the achievement of motor or mental milestones in the domains of development of a child, including motor skills, speech and language, cognitive skills, and social and emotional skills. This term should only be used to describe children younger than five years of age. Evidence: TAS. (OMIM:614702)
- Increased circulating lactate concentration (HP:0002151): Abnormally increased level of blood lactate (2-hydroxypropanoic acid). Lactate is produced from pyruvate by lactate dehydrogenase during normal metabolism. The terms lactate and lactic acid are often used interchangeably but lactate (the component measured in blood) is strictly a weak base whereas lactic acid is the corresponding acid. Lactic acidosis is often used clinically to describe elevated lactate but should be reserved for cases where there is a corresponding acidosis (pH below 7.35). Evidence: PCS. Frequency: 3/3. (PMID:22608499)
- Hypertrophic cardiomyopathy (HP:0001639): Hypertrophic cardiomyopathy (HCM) is defined by the presence of increased ventricular wall thickness or mass in the absence of loading conditions (hypertension, valve disease) sufficient to cause the observed abnormality. Evidence: PCS. Frequency: 2/3. (PMID:22608499)
- Small for gestational age (HP:0001518): Smaller than normal size according to sex and gestational age related norms, defined as a weight below the 10th percentile for the gestational age. Evidence: TAS. (OMIM:614702)
- Autosomal recessive inheritance (HP:0000007): A mode of inheritance that is observed for traits related to a gene encoded on one of the autosomes (i.e., the human chromosomes 1-22) in which a trait manifests in individuals with two pathogenic alleles, either homozygotes (two copies of the same mutant allele) or compound heterozygotes (whereby each copy of a gene has a distinct mutant allele). Evidence: PCS. (PMID:22608499)
- Optic atrophy (HP:0000648): Atrophy of the optic nerve. Optic atrophy results from the death of the retinal ganglion cell axons that comprise the optic nerve and manifesting as a pale optic nerve on fundoscopy. Evidence: PCS. Frequency: 1/3. (PMID:22608499)
- Intrauterine growth retardation (HP:0001511): An abnormal restriction of fetal growth with fetal weight below the tenth percentile for gestational age. Evidence: PCS. Frequency: 2/3. (PMID:22608499)
- Pericardial effusion (HP:0001698): Accumulation of fluid within the pericardium. Evidence: PCS. Frequency: 1/3. (PMID:22608499)
- Spasticity (HP:0001257): A motor disorder characterized by a velocity-dependent increase in tonic stretch reflexes with increased muscle tone, exaggerated (hyperexcitable) tendon reflexes. Evidence: TAS. Frequency: Occasional (HP:0040283). (OMIM:614702)